Phenotypes associated with the disease keratoconus 5 (OMIM:614622):
- Keratoconus (HP:0000563): A cone-shaped deformity of the cornea characterized by the presence of corneal distortion secondary to thinning of the apex. Evidence: TAS. (OMIM:614622)
- Autosomal dominant inheritance (HP:0000006): A mode of inheritance that is observed for traits related to a gene encoded on one of the autosomes (i.e., the human chromosomes 1-22) in which a trait manifests in heterozygotes. In the context of medical genetics, an autosomal dominant disorder is caused when a single copy of the mutant allele is present. Males and females are affected equally, and can both transmit the disorder with a risk of 50% for each child of inheriting the mutant allele. Evidence: TAS. (OMIM:614622)